- Ptosis (HP:0000508): The upper eyelid margin is positioned 3 mm or more lower than usual and covers the superior portion of the iris (objective); or, the upper lid margin obscures at least part of the pupil (subjective). Evidence: TAS. Frequency: Very frequent (HP:0040281). (ORPHA:178487)
- Diplopia (HP:0000651): Diplopia is a condition in which a single object is perceived as two images, it is also known as double vision. Evidence: TAS. Frequency: Very frequent (HP:0040281). (ORPHA:178487)
- Muscle weakness (HP:0001324): Reduced strength of muscles. Evidence: TAS. Frequency: Very frequent (HP:0040281). (ORPHA:178487)
- Diarrhea (HP:0002014): Abnormally increased frequency (usually defined as three or more) loose or watery bowel movements a day. Evidence: TAS. Frequency: Frequent (HP:0040282). (ORPHA:178487)
- Dyspnea (HP:0002094): Difficult or labored breathing. Dyspnea is a subjective feeling only the patient can rate, e.g., on a Borg scale. Evidence: TAS. Frequency: Frequent (HP:0040282). (ORPHA:178487)
- Respiratory insufficiency due to muscle weakness (HP:0002747). Evidence: TAS. Frequency: Frequent (HP:0040282). (ORPHA:178487)
- Diaphragmatic paralysis (HP:0006597): The presence of a paralyzed diaphragm. Evidence: TAS. Frequency: Very frequent (HP:0040281). (ORPHA:178487)
- Cranial nerve paralysis (HP:0006824). Evidence: TAS. Frequency: Very frequent (HP:0040281). (ORPHA:178487)
- Cerebral palsy (HP:0100021): Cerebral palsy describes a group of permanent disorders of the development of movement and posture, causing activity limitation, that are attributed to nonprogressive disturbances that occurred in the developing fetal or infant brain. The motor disorders of cerebral palsy are often accompanied by disturbances of sensation, perception, cognition, communication, and behavior, by epilepsy, and by secondary musculoskeletal problems. Evidence: TAS. Frequency: Very frequent (HP:0040281). (ORPHA:178487)
These phenotypes are associated with the disease Adult intestinal botulism (ORPHA:178487).